- Inappropriate crying (HP:0030215): Uncontrolled episodes of crying occur without any apparent motivating stimuli. Evidence: TAS. Frequency: Frequent (HP:0040282). (ORPHA:225147)
- Abnormality of movement (HP:0100022): An abnormality of movement with a neurological basis characterized by changes in coordination and speed of voluntary movements. Evidence: TAS. Frequency: Frequent (HP:0040282). (ORPHA:225147)
- Urinary incontinence (HP:0000020): Loss of the ability to control the urinary bladder leading to involuntary urination. Evidence: TAS. Frequency: Occasional (HP:0040283). (ORPHA:225147)
- Mask-like facies (HP:0000298): A lack of facial expression often with staring eyes and a slightly open mouth. Evidence: TAS. Frequency: Occasional (HP:0040283). (ORPHA:225147)
- Hypomimic face (HP:0000338): A reduced degree of motion of the muscles beneath the skin of the face, often associated with reduced facial crease formation. Evidence: TAS. Frequency: Occasional (HP:0040283). (ORPHA:225147)
- Short attention span (HP:0000736): Reduced attention span characterized by distractibility and impulsivity. Evidence: TAS. Frequency: Occasional (HP:0040283). (ORPHA:225147)
- Gait disturbance (HP:0001288): The term gait disturbance can refer to any disruption of the ability to walk. Evidence: TAS. Frequency: Occasional (HP:0040283). (ORPHA:225147)
- Parkinsonism (HP:0001300): Characteristic neurologic anomaly resulting from degeneration of dopamine-generating cells in the substantia nigra, a region of the midbrain, characterized clinically by shaking, rigidity, slowness of movement and difficulty with walking and gait. Evidence: TAS. Frequency: Occasional (HP:0040283). (ORPHA:225147)
- Dystonia (HP:0001332): An abnormally increased muscular tone that causes fixed abnormal postures. There is a slow, intermittent twisting motion that leads to exaggerated turning and posture of the extremities and trunk. Evidence: TAS. Frequency: Occasional (HP:0040283). (ORPHA:225147)
- Hyperreflexia (HP:0001347): Hyperreflexia is the presence of hyperactive stretch reflexes of the muscles. Evidence: TAS. Frequency: Occasional (HP:0040283). (ORPHA:225147)
- Poor suck (HP:0002033): An inadequate sucking reflex, resulting in the difficult of newborns to be breast-fed. Evidence: TAS. Frequency: Occasional (HP:0040283). (ORPHA:225147)
- Gait ataxia (HP:0002066): A type of ataxia characterized by the impairment of the ability to coordinate the movements required for normal walking. Gait ataxia is characteirzed by a wide-based staggering gait with a tendency to fall. Evidence: TAS. Frequency: Occasional (HP:0040283). (ORPHA:225147)
- Bradykinesia (HP:0002067): Bradykinesia literally means slow movement, and is used clinically to denote a slowness in the execution of movement (in contrast to hypokinesia, which is used to refer to slowness in the initiation of movement). Evidence: TAS. Frequency: Occasional (HP:0040283). (ORPHA:225147)
- Chorea (HP:0002072): Chorea (Greek for 'dance') refers to widespread arrhythmic involuntary movements of a forcible, jerky and restless fashion. It is a random-appearing sequence of one or more discrete involuntary movements or movement fragments. Movements appear random because of variability in timing, duration or location. Each movement may have a distinct start and end. However, movements may be strung together and thus may appear to flow randomly from one muscle group to another. Chorea can involve the trunk, neck, face, tongue, and extremities. Evidence: TAS. Frequency: Occasional (HP:0040283). (ORPHA:225147)
- Mutism (HP:0002300): Complete lack of speech or verbal communication in a person despite attempts to engage in conversation. Mutism as a phenomena assumes the individual has previous capacity for speech and in the pediatric population it assumes that the person is past the age of typical language development. Evidence: TAS. Frequency: Occasional (HP:0040283). (ORPHA:225147)
- Hemiplegia (HP:0002301): Paralysis (complete loss of muscle function) in the arm, leg, and in some cases the face on one side of the body. Evidence: TAS. Frequency: Occasional (HP:0040283). (ORPHA:225147)
- Drooling (HP:0002307): Habitual flow of saliva out of the mouth. Evidence: TAS. Frequency: Occasional (HP:0040283). (ORPHA:225147)
- Resting tremor (HP:0002322): A resting tremor occurs when muscles are at rest and becomes less noticeable or disappears when the affected muscles are moved. Resting tremors are often slow and coarse. Evidence: TAS. Frequency: Occasional (HP:0040283). (ORPHA:225147)
- Poor speech (HP:0002465). Evidence: TAS. Frequency: Occasional (HP:0040283). (ORPHA:225147)
- Babinski sign (HP:0003487): Upturning of the big toe (and sometimes fanning of the other toes) in response to stimulation of the sole of the foot. If the Babinski sign is present it can indicate damage to the corticospinal tract. Evidence: TAS. Frequency: Occasional (HP:0040283). (ORPHA:225147)
- Reduced consciousness (HP:0004372): Abnormally diminished level of attention, responsiveness, or wakefulness. Evidence: TAS. Frequency: Occasional (HP:0040283). (ORPHA:225147)
- Recurrent streptococcus pneumoniae infections (HP:0005366): Increased susceptibility to streptococcus pneumoniae infections as manifested by a history of recurrent infections by streptococcus pneumoniae. Evidence: TAS. Frequency: Occasional (HP:0040283). (ORPHA:225147)
- Progressive extrapyramidal muscular rigidity (HP:0007158): A progressive degree of muscular rigidity (continuous contraction of muscles with constant resistance to passive movement). Evidence: TAS. Frequency: Occasional (HP:0040283). (ORPHA:225147)
- Loss of consciousness (HP:0007185): Loss of awareness of oneself or one's surroundings, involving (i) a loss of normal motor control is evident as flaccidity or stiffness, either of which can be accompanied by jerking movements, and postural control is lost so that patients fall if they are in an upright position; (ii) normal responsiveness is lost; and (iii) the patient experiences amnesia for the event. Loss of consciousness my be transitory (e.g., syncope) or prolonged. Evidence: TAS. Frequency: Occasional (HP:0040283). (ORPHA:225147)
- Focal-onset seizure (HP:0007359): A focal-onset seizure is a type of seizure originating within networks limited to one hemisphere. They may be discretely localized or more widely distributed, and may originate in subcortical structures. Evidence: TAS. Frequency: Occasional (HP:0040283). (ORPHA:225147)
- Floppy infant (HP:0008947): Floppiness/hypotonia is defined as reduced resistance to passive movement of joints. Physical examination of floppy/hypotonic infants shows head lag, lack of shoulder and elbow muscle contraction on traction response, inability to tighten the shoulder girdle muscles (or slipping through) when held under the axillae, scarf sign (when the arm is pulled to the opposite side, the arm wraps around the neck with the elbow crossing midline), hyperdorsiflexion of the feet, easy apposition of the thumb against the forearm, feet touching the cheek with ease and without discomfort, frog leg position, and inverted U sign on ventral suspension (head, arms, and legs hanging down without elbow or knee flexion and the trunk rounded in a dome shape). Evidence: TAS. Frequency: Occasional (HP:0040283). (ORPHA:225147)
- Atypical absence status epilepticus (HP:0011151): Atypical absence status epilepticus is a type of generalized non-convulsive status epilepticus without coma that is semiologically a prolonged atypical absence seizure. Evidence: TAS. Frequency: Occasional (HP:0040283). (ORPHA:225147)
- Pharyngitis (HP:0025439): Inflammation (due to infection or irritation) of the pharynx. Evidence: TAS. Frequency: Occasional (HP:0040283). (ORPHA:225147)
- Titubation (HP:0030187): Nodding movement of the head or body. Evidence: TAS. Frequency: Occasional (HP:0040283). (ORPHA:225147)
- Nasogastric tube feeding (HP:0040288): The condition of inability to eat normally treated by placement of a thin tube through the nose into the stomach that is then used to carry food. Evidence: TAS. Frequency: Occasional (HP:0040283). (ORPHA:225147)
- Facial grimacing (HP:0000273). Evidence: TAS. Frequency: Frequent (HP:0040282). (ORPHA:225147)
- Seizure (HP:0001250): A seizure is an intermittent abnormality of nervous system physiology characterized by a transient occurrence of signs and/or symptoms due to abnormal excessive or synchronous neuronal activity in the brain. Evidence: TAS. Frequency: Frequent (HP:0040282). (ORPHA:225147)
- Dysarthria (HP:0001260): Dysarthric speech is a general description referring to a neurological speech disorder characterized by poor articulation. Depending on the involved neurological structures, dysarthria may be further classified as spastic, flaccid, ataxic, hyperkinetic and hypokinetic, or mixed. Evidence: TAS. Frequency: Frequent (HP:0040282). (ORPHA:225147)
- Specific learning disability (HP:0001328): Impairment of certain skills such as reading or writing, coordination, self-control, or attention that interfere with the ability to learn. The impairment is not related to a global deficiency of intelligence. Evidence: TAS. Frequency: Frequent (HP:0040282). (ORPHA:225147)
- Dysphagia (HP:0002015): Difficulty in swallowing. Evidence: TAS. Frequency: Frequent (HP:0040282). (ORPHA:225147)
- Abnormal posturing (HP:0002533): Involuntary flexion or extension of the arms and legs. Evidence: TAS. Frequency: Frequent (HP:0040282). (ORPHA:225147)
- Recurrent upper respiratory tract infections (HP:0002788): An increased susceptibility to upper respiratory tract infections as manifested by a history of recurrent upper respiratory tract infections (running ears - otitis, sinusitis, pharyngitis, tonsillitis). Evidence: TAS. Frequency: Frequent (HP:0040282). (ORPHA:225147)
- Axial hypotonia (HP:0008936): Muscular hypotonia (abnormally low muscle tone) affecting the musculature of the trunk. Evidence: TAS. Frequency: Frequent (HP:0040282). (ORPHA:225147)
These phenotypes are associated with the disease Sporadic infantile bilateral striatal necrosis (ORPHA:225147).